Phenotypes associated with the disease prolonged electroretinal response suppression 1 (OMIM:608415):
- Difficulty adjusting to changes in luminance (HP:0030512). Evidence: PCS. Frequency: 5/5. (PMID:14702087;PMID:19818506)
- Bradyopsia (HP:0030511): Difficulty in seeing moving objects. Evidence: PCS. Frequency: 5/5. (PMID:14702087;PMID:19818506)
- Childhood onset (HP:0011463): Onset of disease at the age of between 1 and 5 years. Evidence: PCS. Frequency: 5/5. (PMID:14702087;PMID:19818506)
- Photophobia (HP:0000613): Excessive sensitivity to light with the sensation of discomfort or pain in the eyes due to exposure to bright light. Evidence: PCS. Frequency: 5/5. (PMID:14702087;PMID:19818506)
- Reduced visual acuity (HP:0007663). Evidence: PCS. Frequency: 5/5. (PMID:14702087;PMID:19818506)
- Autosomal recessive inheritance (HP:0000007): A mode of inheritance that is observed for traits related to a gene encoded on one of the autosomes (i.e., the human chromosomes 1-22) in which a trait manifests in individuals with two pathogenic alleles, either homozygotes (two copies of the same mutant allele) or compound heterozygotes (whereby each copy of a gene has a distinct mutant allele). Evidence: PCS. (PMID:14702087)